Phenotypes associated with the disease spermatogenic failure 102 (OMIM:621387):
- Irregularly shaped sperm tail (HP:0033393): Irregular or changing caliber (diameter) along the tail of the sperm. Evidence: PCS. Frequency: 1/1. (PMID:34255152)
- Coiled sperm flagella (HP:0032560): Sperm cells whose flagella are twisted (coiled). Evidence: PCS. Frequency: 1/1. (PMID:34255152)
- Male infertility (HP:0003251). Evidence: PCS. Frequency: 1/1. (PMID:34255152)
- Young adult onset (HP:0011462): Onset of disease at the age of between 16 and 40 years. Evidence: PCS. Frequency: 1/1. (PMID:34255152)
- Tapered sperm head (HP:0032562): Sperm with cigar-shaped heads that gradually dimish in diameter (taper). Evidence: PCS. Frequency: 1/1. (PMID:34255152)
- Autosomal recessive inheritance (HP:0000007): A mode of inheritance that is observed for traits related to a gene encoded on one of the autosomes (i.e., the human chromosomes 1-22) in which a trait manifests in individuals with two pathogenic alleles, either homozygotes (two copies of the same mutant allele) or compound heterozygotes (whereby each copy of a gene has a distinct mutant allele). Evidence: PCS. (PMID:34255152)
- Immotile sperm (HP:0012208): A lack of mobility of ejaculated sperm. Evidence: PCS. Frequency: 1/1. (PMID:34255152)
- Absent sperm flagella (HP:0032558): Sperm cells lacking flagella. Evidence: PCS. Frequency: 1/1. (PMID:34255152)
- Short sperm flagella (HP:0032559): Sperm cells with abnormally short flagella. Evidence: PCS. Frequency: 1/1. (PMID:34255152)